Phenotypes associated with the disease Cornelia de Lange syndrome (ORPHA:199):
- High palate (HP:0000218): Height of the palate more than 2 SD above the mean (objective) or palatal height at the level of the first permanent molar more than twice the height of the teeth (subjective). Evidence: TAS. Frequency: Very frequent (HP:0040281). (ORPHA:199)
- Thin vermilion border (HP:0000233): Height of the vermilion of the medial part of the lip more than 2 SD below the mean, or apparently reduced height of the vermilion of the lip in the frontal view. The vermilion is the red part of the lips (and confusingly, the vermilion itself is also often referred to as being equivalent the lips). Evidence: TAS. Frequency: Very frequent (HP:0040281). (ORPHA:199)
- Brachycephaly (HP:0000248): An abnormality of skull shape characterized by a decreased anterior-posterior diameter. That is, a cephalic index greater than 81%. Alternatively, an apparently shortened anteroposterior dimension (length) of the head compared to width. Evidence: TAS. Frequency: Very frequent (HP:0040281). (ORPHA:199)
- Microcephaly (HP:0000252): Head circumference below 2 standard deviations below the mean for age and gender. Evidence: TAS. Frequency: Very frequent (HP:0040281). (ORPHA:199)
- Low anterior hairline (HP:0000294): Distance between the hairline (trichion) and the glabella (the most prominent point on the frontal bone above the root of the nose), in the midline, more than two SD below the mean. Alternatively, an apparently decreased distance between the hairline and the glabella. Evidence: TAS. Frequency: Very frequent (HP:0040281). (ORPHA:199)
- Long philtrum (HP:0000343): Distance between nasal base and midline upper lip vermilion border more than 2 SD above the mean. Alternatively, an apparently increased distance between nasal base and midline upper lip vermilion border. Evidence: TAS. Frequency: Very frequent (HP:0040281). (ORPHA:199)
- Micrognathia (HP:0000347): Developmental hypoplasia of the mandible. Evidence: TAS. Frequency: Very frequent (HP:0040281). (ORPHA:199)
- Atresia of the external auditory canal (HP:0000413): Absence or failure to form of the external auditory canal. Evidence: TAS. Frequency: Very frequent (HP:0040281). (ORPHA:199)
- Anteverted nares (HP:0000463): Anteriorly-facing nostrils viewed with the head in the Frankfurt horizontal and the eyes of the observer level with the eyes of the subject. This gives the appearance of an upturned nose (upturned nasal tip). Evidence: TAS. Frequency: Very frequent (HP:0040281). (ORPHA:199)
- Short neck (HP:0000470): Diminished length of the neck. Evidence: TAS. Frequency: Very frequent (HP:0040281). (ORPHA:199)
- Long eyelashes (HP:0000527): Mid upper eyelash length >10 mm or increased length of the eyelashes (subjective). Evidence: TAS. Frequency: Very frequent (HP:0040281). (ORPHA:199)
- Thick eyebrow (HP:0000574): Increased density/number and/or increased diameter of eyebrow hairs. Evidence: TAS. Frequency: Very frequent (HP:0040281). (ORPHA:199)
- Synophrys (HP:0000664): Meeting of the medial eyebrows in the midline. Evidence: TAS. Frequency: Very frequent (HP:0040281). (ORPHA:199)
- Delayed eruption of teeth (HP:0000684): Delayed tooth eruption, which can be defined as tooth eruption more than 2 SD beyond the mean eruption age. Evidence: TAS. Frequency: Very frequent (HP:0040281). (ORPHA:199)
- Widely spaced teeth (HP:0000687): Increased spaces (diastemata) between most of the teeth in the same dental arch. Evidence: TAS. Frequency: Very frequent (HP:0040281). (ORPHA:199)
- Intellectual disability (HP:0001249): The term intellectual disability or intellectual developmental disorder is used to describe significantly sub-average intellectual and adaptive functioning based on clinical assessment and as measured by individually administered, appropriately normed, standardized and validated tests of intellectual functioning and adaptive behavior, with onset during the developmental period from infancy through adolescence. Evidence: TAS. Frequency: Very frequent (HP:0040281). (ORPHA:199)
- Hypertonia (HP:0001276): A condition in which there is increased muscle tone so that arms or legs, for example, are stiff and difficult to move. Evidence: TAS. Frequency: Very frequent (HP:0040281). (ORPHA:199)
- Toe syndactyly (HP:0001770): Webbing or fusion of the toes, involving soft parts only or including bone structure. Bony fusions are referred to as "bony" Syndactyly if the fusion occurs in a radio-ulnar axis. Fusions of bones of the toes in a proximo-distal axis are referred to as "Symphalangism". Evidence: TAS. Frequency: Very frequent (HP:0040281). (ORPHA:199)
- Short foot (HP:0001773): A measured foot length that is more than 2 SD below the mean for a newborn of 27 - 41 weeks gestation, or foot that is less than the 3rd centile for individuals from birth to 16 years of age (objective). Alternatively, a foot that appears disproportionately short (subjective). Evidence: TAS. Frequency: Very frequent (HP:0040281). (ORPHA:199)
- Gastroesophageal reflux (HP:0002020): A condition in which the stomach contents leak backwards from the stomach into the esophagus through the lower esophageal sphincter. Evidence: TAS. Frequency: Very frequent (HP:0040281). (ORPHA:199)
- Low posterior hairline (HP:0002162): Hair on the neck extends more inferiorly than usual. Evidence: TAS. Frequency: Very frequent (HP:0040281). (ORPHA:199)
- Generalized hirsutism (HP:0002230): Abnormally increased hair growth over much of the entire body. Evidence: TAS. Frequency: Very frequent (HP:0040281). (ORPHA:199)
- Highly arched eyebrow (HP:0002553): Increased height of the central portion of the eyebrow, forming a crescent, semicircular, or inverted U shape. Evidence: TAS. Frequency: Very frequent (HP:0040281). (ORPHA:199)
- Downturned corners of mouth (HP:0002714): A morphological abnormality of the mouth in which the angle of the mouth is downturned. The oral commissures are positioned inferior to the midline labial fissure. Evidence: TAS. Frequency: Very frequent (HP:0040281). (ORPHA:199)
- Delayed skeletal maturation (HP:0002750): A decreased rate of skeletal maturation. Delayed skeletal maturation can be diagnosed on the basis of an estimation of the bone age from radiographs of specific bones in the human body. Evidence: TAS. Frequency: Very frequent (HP:0040281). (ORPHA:199)
- Micromelia (HP:0002983): The presence of abnormally small extremities. Evidence: TAS. Frequency: Very frequent (HP:0040281). (ORPHA:199)
- Short nose (HP:0003196): Distance from nasion to subnasale more than two standard deviations below the mean, or alternatively, an apparently decreased length from the nasal root to the nasal tip. Evidence: TAS. Frequency: Very frequent (HP:0040281). (ORPHA:199)
- Short stature (HP:0004322): A height below that which is expected according to age and gender norms. Although there is no universally accepted definition of short stature, many refer to "short stature" as height more than 2 standard deviations below the mean for age and gender (or below the 3rd percentile for age and gender dependent norms). Evidence: TAS. Frequency: Very frequent (HP:0040281). (ORPHA:199)
- Depressed nasal bridge (HP:0005280): Posterior positioning of the nasal root in relation to the overall facial profile for age. Evidence: TAS. Frequency: Very frequent (HP:0040281). (ORPHA:199)
- Curly eyelashes (HP:0007665): Abnormally curly or curved eyelashes. Evidence: TAS. Frequency: Very frequent (HP:0040281). (ORPHA:199)
- Proximal placement of thumb (HP:0009623): Proximal mislocalization of the thumb. Evidence: TAS. Frequency: Very frequent (HP:0040281). (ORPHA:199)
- Short 1st metacarpal (HP:0010034): A developmental defect characterized by reduced length of the first metacarpal (long bone) of the hand. Evidence: TAS. Frequency: Very frequent (HP:0040281). (ORPHA:199)
- Abnormally low-pitched voice (HP:0010300): A persistent (minutes to hours) abnormal decrease in the pitch of the voice for the context or social situation or significantly different from the baseline of the individual. Evidence: TAS. Frequency: Very frequent (HP:0040281). (ORPHA:199)
- Severe intellectual disability (HP:0010864): Severe intellectual disability (ID) is defined as a type of ID characterized by severely sub-average adaptive functioning and intellectual functioning, with an intelligence quotient (IQ) the range of 20-34. Evidence: TAS. Frequency: Very frequent (HP:0040281). (ORPHA:199)
- Small hand (HP:0200055): Disproportionately small hand. Evidence: TAS. Frequency: Very frequent (HP:0040281). (ORPHA:199)
- Multicystic kidney dysplasia (HP:0000003): Multicystic dysplasia of the kidney is characterized by multiple cysts of varying size in the kidney and the absence of a normal pelvicaliceal system. The condition is associated with ureteral or ureteropelvic atresia, and the affected kidney is nonfunctional. Evidence: TAS. Frequency: Frequent (HP:0040282). (ORPHA:199)
- Cryptorchidism (HP:0000028): Testis in inguinal canal. That is, absence of one or both testes from the scrotum owing to failure of the testis or testes to descend through the inguinal canal to the scrotum. Evidence: TAS. Frequency: Frequent (HP:0040282). (ORPHA:199)
- Hypospadias (HP:0000047): Abnormal position of urethral meatus on the ventral penile shaft (underside) characterized by displacement of the urethral meatus from the tip of the glans penis to the ventral surface of the penis, scrotum, or perineum. Evidence: TAS. Frequency: Frequent (HP:0040282). (ORPHA:199)
- Hypoplastic labia majora (HP:0000059): Undergrowth of the outer labia. Evidence: TAS. Frequency: Frequent (HP:0040282). (ORPHA:199)
- Vesicoureteral reflux (HP:0000076): Abnormal (retrograde) movement of urine from the bladder into ureters or kidneys related to inadequacy of the valvular mechanism at the ureterovesicular junction or other causes. Evidence: TAS. Frequency: Frequent (HP:0040282). (ORPHA:199)
- Conductive hearing impairment (HP:0000405): An abnormality of vibrational conductance of sound to the inner ear leading to impairment of sensory perception of sound. Evidence: TAS. Frequency: Frequent (HP:0040282). (ORPHA:199)
- Sensorineural hearing impairment (HP:0000407): A type of hearing impairment in one or both ears related to an abnormal functionality of the cochlear nerve. Evidence: TAS. Frequency: Frequent (HP:0040282). (ORPHA:199)
- Microcornea (HP:0000482): A congenital abnormality of the cornea in which the cornea and the anterior segment of the eye are smaller than normal. The horizontal diameter of the cornea does not reach 10 mm even in adulthood. Evidence: TAS. Frequency: Frequent (HP:0040282). (ORPHA:199)
- Blepharitis (HP:0000498): Inflammation of the eyelids. Evidence: TAS. Frequency: Frequent (HP:0040282). (ORPHA:199)
- Ptosis (HP:0000508): The upper eyelid margin is positioned 3 mm or more lower than usual and covers the superior portion of the iris (objective); or, the upper lid margin obscures at least part of the pupil (subjective). Evidence: TAS. Frequency: Frequent (HP:0040282). (ORPHA:199)
- Myopia (HP:0000545): An abnormality of refraction characterized by the ability to see objects nearby clearly, while objects in the distance appear blurry. Evidence: TAS. Frequency: Frequent (HP:0040282). (ORPHA:199)
- Phthisis bulbi (HP:0000667): Atrophy of the eyeball with blindness and decreased intraocular pressure due to end-stage intraocular disease. Evidence: TAS. Frequency: Frequent (HP:0040282). (ORPHA:199)
- Compulsive behaviors (HP:0000722): Behavior that consists of repetitive acts, characterized by the feeling that one "has to" perform them, while being aware that these acts are not in line with one's overall goal. Evidence: TAS. Frequency: Frequent (HP:0040282). (ORPHA:199)
- Anxiety (HP:0000739): Intense feelings of nervousness, tension, or panic often arise in response to interpersonal stresses. There is worry about the negative effects of past unpleasant experiences and future negative possibilities. Individuals may feel fearful, apprehensive, or threatened by uncertainty, and they may also have fears of falling apart or losing control. Evidence: TAS. Frequency: Frequent (HP:0040282). (ORPHA:199)
- Cutis marmorata (HP:0000965): A reticular discoloration of the skin with cyanotic (reddish-blue appearing) areas surrounding pale central areas due to dilation of capillary blood vessels and stagnation of blood within the vessels. Cutis marmorata generally occurs on the legs, arms and trunk and is often more severe in cold weather. Evidence: TAS. Frequency: Frequent (HP:0040282). (ORPHA:199)
- Joint stiffness (HP:0001387): Joint stiffness is a perceived sensation of tightness in a joint or joints when attempting to move them after a period of inactivity. Joint stiffness typically subsides over time. Evidence: TAS. Frequency: Frequent (HP:0040282). (ORPHA:199)
- Failure to thrive (HP:0001508): Failure to thrive (FTT) refers to a child whose physical growth is substantially below the norm. Evidence: TAS. Frequency: Frequent (HP:0040282). (ORPHA:199)
- Intrauterine growth retardation (HP:0001511): An abnormal restriction of fetal growth with fetal weight below the tenth percentile for gestational age. Evidence: TAS. Frequency: Frequent (HP:0040282). (ORPHA:199)
- Premature birth (HP:0001622): The birth of a baby of less than 37 weeks of gestational age. Evidence: TAS. Frequency: Frequent (HP:0040282). (ORPHA:199)
- Abnormal speech pattern (HP:0002167): An abnormality in the sound (volume) or cadence (rate) of speech. Evidence: TAS. Frequency: Frequent (HP:0040282). (ORPHA:199)
- Sleep disturbance (HP:0002360): An abnormal pattern in the quality, quantity, or characteristics of sleep. Evidence: TAS. Frequency: Frequent (HP:0040282). (ORPHA:199)
- Hypoplastic nipples (HP:0002557): Underdevelopment of the nipple. Evidence: TAS. Frequency: Frequent (HP:0040282). (ORPHA:199)
- Radioulnar synostosis (HP:0002974): An abnormal osseous union (fusion) between the radius and the ulna. Evidence: TAS. Frequency: Frequent (HP:0040282). (ORPHA:199)
- Elbow dislocation (HP:0003042): Dislocation of the distal humerus out of the elbow joint, where the radius, ulna, and humerus meet. Evidence: TAS. Frequency: Frequent (HP:0040282). (ORPHA:199)
- Clinodactyly of the 5th finger (HP:0004209): Clinodactyly refers to a bending or curvature of the fifth finger in the radial direction (i.e., towards the 4th finger). Evidence: TAS. Frequency: Frequent (HP:0040282). (ORPHA:199)
- Attention deficit hyperactivity disorder (HP:0007018): Attention deficit hyperactivity disorder (ADHD) manifests at age 2-3 years or by first grade at the latest. The main symptoms are distractibility, impulsivity, hyperactivity, and often trouble organizing tasks and projects, difficulty going to sleep, and social problems from being aggressive, loud, or impatient. Evidence: TAS. Frequency: Frequent (HP:0040282). (ORPHA:199)
- Bilateral single transverse palmar creases (HP:0007598): The distal and proximal transverse palmar creases are merged into a single transverse palmar crease on both hands. Evidence: TAS. Frequency: Frequent (HP:0040282). (ORPHA:199)
- Hypoplasia of penis (HP:0008736). Evidence: TAS. Frequency: Frequent (HP:0040282). (ORPHA:199)
- Severe postnatal growth retardation (HP:0008850): Severely slow or limited growth after birth, being four standard deviations or more below age- and sex-related norms. Evidence: TAS. Frequency: Frequent (HP:0040282). (ORPHA:199)
- Feeding difficulties in infancy (HP:0008872): Impaired feeding performance of an infant as manifested by difficulties such as weak and ineffective sucking, brief bursts of sucking, and falling asleep during sucking. There may be difficulties with chewing or maintaining attention. Evidence: TAS. Frequency: Frequent (HP:0040282). (ORPHA:199)
- Renal insufficiency (HP:0000083): A reduction in the level of performance of the kidneys in areas of function comprising the concentration of urine, removal of wastes, the maintenance of electrolyte balance, homeostasis of blood pressure, and calcium metabolism. Evidence: TAS. Frequency: Occasional (HP:0040283). (ORPHA:199)
- Abnormality of the uterus (HP:0000130): An abnormality of the uterus. Evidence: TAS. Frequency: Occasional (HP:0040283). (ORPHA:199)
- Cleft palate (HP:0000175): Cleft palate is a developmental defect of the palate resulting from a failure of fusion of the palatine processes and manifesting as a separation of the roof of the mouth (soft and hard palate). Evidence: TAS. Frequency: Occasional (HP:0040283). (ORPHA:199)
- Macrotia (HP:0000400): Median longitudinal ear length greater than two standard deviations above the mean and median ear width greater than two standard deviations above the mean (objective); or, apparent increase in length and width of the pinna (subjective). Evidence: TAS. Frequency: Occasional (HP:0040283). (ORPHA:199)
- Choanal atresia (HP:0000453): Absence or abnormal closure of the choana (the posterior nasal aperture). Most embryologists believe that posterior choanal atresia results from a failure of rupture between the 35th and 38th day of fetal life of the partition which separates the bucconasal or buccopharyngeal membranes. The resultant choanal atresia may be unilateral or bilateral, bony or membranous, complete or incomplete. In over 90 per cent of cases the obstruction is bony, while in the remainder it is membranous. The bony type of atresia is commonly located 1-2 mm. anterior to the posterior edge of the hard palate, and the osseous septum varies in thickness from 1 to 10 mm. In the membranous form of choanal atresia the obstruction usually occurs further posteriorly. In approximately one third of cases the atresia is bilateral. Evidence: TAS. Frequency: Occasional (HP:0040283). (ORPHA:199)
- Strabismus (HP:0000486): A misalignment of the eyes so that the visual axes deviate from bifoveal fixation. The classification of strabismus may be based on a number of features including the relative position of the eyes, whether the deviation is latent or manifest, intermittent or constant, concomitant or otherwise and according to the age of onset and the relevance of any associated refractive error. Evidence: TAS. Frequency: Occasional (HP:0040283). (ORPHA:199)
- Glaucoma (HP:0000501): Glaucoma refers loss of retinal ganglion cells in a characteristic pattern of optic neuropathy usually associated with increased intraocular pressure. Evidence: TAS. Frequency: Occasional (HP:0040283). (ORPHA:199)
- Cataract (HP:0000518): A cataract is an opacity or clouding that develops in the crystalline lens of the eye or in its capsule. Evidence: TAS. Frequency: Occasional (HP:0040283). (ORPHA:199)
- Nystagmus (HP:0000639): Rhythmic, involuntary oscillations of one or both eyes related to abnormality in fixation, conjugate gaze, or vestibular mechanisms. Evidence: TAS. Frequency: Occasional (HP:0040283). (ORPHA:199)
- Autism (HP:0000717): Autism is a neurodevelopmental disorder characterized by impaired social interaction and communication, and by restricted and repetitive behavior. Autism begins in childhood. It is marked by the presence of markedly abnormal or impaired development in social interaction and communication and a markedly restricted repertoire of activity and interest. Manifestations of the disorder vary greatly depending on the developmental level and chronological age of the individual (DSM-IV). Evidence: TAS. Frequency: Occasional (HP:0040283). (ORPHA:199)
- Pectus excavatum (HP:0000767): A defect of the chest wall characterized by a depression of the sternum, giving the chest ("pectus") a caved-in ("excavatum") appearance. Evidence: TAS. Frequency: Occasional (HP:0040283). (ORPHA:199)
- Congenital diaphragmatic hernia (HP:0000776): The presence of a hernia of the diaphragm present at birth. Evidence: TAS. Frequency: Occasional (HP:0040283). (ORPHA:199)
- Primary amenorrhea (HP:0000786). Evidence: TAS. Frequency: Occasional (HP:0040283). (ORPHA:199)
- Delayed puberty (HP:0000823): Passing the age when puberty normally occurs with no physical or hormonal signs of the onset of puberty. Evidence: TAS. Frequency: Occasional (HP:0040283). (ORPHA:199)
- Seizure (HP:0001250): A seizure is an intermittent abnormality of nervous system physiology characterized by a transient occurrence of signs and/or symptoms due to abnormal excessive or synchronous neuronal activity in the brain. Evidence: TAS. Frequency: Occasional (HP:0040283). (ORPHA:199)
- Hypotonia (HP:0001252): Hypotonia is an abnormally low muscle tone (the amount of tension or resistance to movement in a muscle). Even when relaxed, muscles have a continuous and passive partial contraction which provides some resistance to passive stretching. Hypotonia thus manifests as diminished resistance to passive stretching. Hypotonia is not the same as muscle weakness, although the two conditions can co-exist. Evidence: TAS. Frequency: Occasional (HP:0040283). (ORPHA:199)
- Hip dysplasia (HP:0001385): The presence of developmental dysplasia of the hip. Evidence: TAS. Frequency: Occasional (HP:0040283). (ORPHA:199)
- Prenatal movement abnormality (HP:0001557): An abnormality of fetal movement. Evidence: TAS. Frequency: Occasional (HP:0040283). (ORPHA:199)
- Ventricular septal defect (HP:0001629): A hole between the two bottom chambers (ventricles) of the heart. The defect is centered around the most superior aspect of the ventricular septum. Evidence: TAS. Frequency: Occasional (HP:0040283). (ORPHA:199)
- Atrial septal defect (HP:0001631): Atrial septal defect (ASD) is a congenital abnormality of the interatrial septum that enables blood flow between the left and right atria via the interatrial septum. Evidence: TAS. Frequency: Occasional (HP:0040283). (ORPHA:199)
- Talipes (HP:0001883): A deformity of foot and ankle that has different subtypes that are talipes equinovarus, talipes equinovalgus, talipes calcaneovarus and talipes calcaneovalgus. Evidence: TAS. Frequency: Occasional (HP:0040283). (ORPHA:199)
- Truncal obesity (HP:0001956): Obesity located preferentially in the trunk of the body as opposed to the extremities. Evidence: TAS. Frequency: Occasional (HP:0040283). (ORPHA:199)
- Pyloric stenosis (HP:0002021): Pyloric stenosis, also known as infantile hypertrophic pyloric stenosis, is an uncommon condition in infants characterized by abnormal thickening of the pylorus muscles in the stomach leading to gastric outlet obstruction. Clinically infants are well at birth. Then, at 3 to 6 weeks of age, the infants present with projectile vomiting, potentially leading to dehydration and weight loss. Evidence: TAS. Frequency: Occasional (HP:0040283). (ORPHA:199)
- Ventriculomegaly (HP:0002119): An increase in size of the ventricular system of the brain. Evidence: TAS. Frequency: Occasional (HP:0040283). (ORPHA:199)
- Cerebral cortical atrophy (HP:0002120): Atrophy of the cortex of the cerebrum. Evidence: TAS. Frequency: Occasional (HP:0040283). (ORPHA:199)
- Intestinal malrotation (HP:0002566): An abnormality of the intestinal rotation and fixation that normally occurs during the development of the gut. This can lead to volvulus, or twisting of the intestine that causes obstruction and necrosis. Evidence: TAS. Frequency: Occasional (HP:0040283). (ORPHA:199)
- Volvulus (HP:0002580): Abnormal twisting of a portion of intestine around itself or around a stalk of mesentery tissue. Evidence: TAS. Frequency: Occasional (HP:0040283). (ORPHA:199)
- Hip dislocation (HP:0002827): Displacement of the femur from its normal location in the hip joint. Evidence: TAS. Frequency: Occasional (HP:0040283). (ORPHA:199)
- Aplasia/Hypoplasia of the cerebellum (HP:0007360). Evidence: TAS. Frequency: Occasional (HP:0040283). (ORPHA:199)
- Peripheral neuropathy (HP:0009830): Peripheral neuropathy is a general term for any disorder of the peripheral nervous system. The main clinical features used to classify peripheral neuropathy are distribution, type (mainly demyelinating versus mainly axonal), duration, and course. Evidence: TAS. Frequency: Occasional (HP:0040283). (ORPHA:199)
- Increased nuchal translucency (HP:0010880): Nuchal translucency is the sonographic appearance of subcutaneous accumulation of liquid in the back of the fetal neck in the first trimester of pregnancy (11-14 gestational weeks of pregnancy). Evidence: TAS. Frequency: Occasional (HP:0040283). (ORPHA:199)
- Oligodactyly (HP:0012165): A developmental defect resulting in the presence of fewer than the normal number of digits. Evidence: TAS. Frequency: Occasional (HP:0040283). (ORPHA:199)
- Abnormal cardiovascular system morphology (HP:0030680): Any structural anomaly of the heart and blood vessels. Evidence: TAS. Frequency: Occasional (HP:0040283). (ORPHA:199)
- Abnormal morphology of ulna (HP:0040071): Any structural anomaly of the ulna, a bone of the forearm the extends from the elbow to the little finger. Evidence: TAS. Frequency: Occasional (HP:0040283). (ORPHA:199)
- Posteriorly rotated ears (HP:0000358): A type of abnormal location of the ears in which the position of the ears is characterized by posterior rotation (the superior part of the ears is rotated towards the back of the head, and the inferior part of the ears towards the front). Evidence: TAS. Frequency: Frequent (HP:0040282). (ORPHA:199)